- Status epilepticus (HP:0002133): Status epilepticus is a type of prolonged seizure resulting either from the failure of the mechanisms responsible for seizure termination or from the initiation of mechanisms which lead to abnormally prolonged seizures (after time point t1). It is a condition that can have long-term consequences (after time point t2), including neuronal death, neuronal injury, and alteration of neuronal networks, depending on the type and duration of seizures. Evidence: TAS. Frequency: Occasional (HP:0040283). (ORPHA:1941)
- Febrile seizure (within the age range of 3 months to 6 years) (HP:0002373): A febrile seizure is any type of seizure (most often a generalized tonic-clonic seizure) occurring with fever (at least 38 degrees Celsius) but in the absence of central nervous system infection, severe metabolic disturbance or other alternative precipitant in children between the ages of 3 months and 6 years. Evidence: TAS. Frequency: Occasional (HP:0040283). (ORPHA:1941)
- Myoclonic seizure (HP:0032794): A myoclonic seizure is a type of motor seizure characterized by sudden, brief (<100 ms) involuntary single or multiple contraction of muscles or muscle groups of variable topography (axial, proximal limb, distal). Myoclonus is less regularly repetitive and less sustained than is clonus. Evidence: TAS. Frequency: Occasional (HP:0040283). (ORPHA:1941)
- Abnormal emotional state (HP:0100851): A disturbance in the experience or expression of emotion, characterized by alterations in valence, intensity, frequency, or duration. It may also involve emotional responses that are mismatched, exaggerated, or incongruent relative to internal expectations or external contextual stimuli, such as experiencing negative affect in response to neutral or positive events. Evidence: TAS. Frequency: Occasional (HP:0040283). (ORPHA:1941)
- Bilateral tonic-clonic seizure (HP:0002069): A bilateral tonic-clonic seizure is a seizure defined by a tonic (bilateral increased tone, lasting seconds to minutes) and then a clonic (bilateral sustained rhythmic jerking) phase. Evidence: TAS. Frequency: Very frequent (HP:0040281). (ORPHA:1941)
- Generalized-onset seizure (HP:0002197): A generalized-onset seizure is a type of seizure originating at some point within, and rapidly engaging, bilaterally distributed networks. The networks may include cortical and subcortical structures but not necessarily the entire cortex. Evidence: TAS. Frequency: Very frequent (HP:0040281). (ORPHA:1941)
- EEG with polyspike wave complexes (HP:0002392): The presence of complexes of repetitive spikes and waves in EEG. Evidence: TAS. Frequency: Very frequent (HP:0040281). (ORPHA:1941)
- Abnormality of the mouth (HP:0000153): An abnormality of the mouth. Evidence: TAS. Frequency: Frequent (HP:0040282). (ORPHA:1941)
- Abnormality of eye movement (HP:0000496): An abnormality in voluntary or involuntary eye movements or their control. Evidence: TAS. Frequency: Frequent (HP:0040282). (ORPHA:1941)
- Myoclonus (HP:0001336): Very brief, involuntary random muscular contractions occurring at rest, in response to sensory stimuli, or accompanying voluntary movements. Evidence: TAS. Frequency: Frequent (HP:0040282). (ORPHA:1941)
- Generalized non-motor (absence) seizure (HP:0002121): A generalized non-motor (absence) seizure is a type of a type of dialeptic seizure that is of electrographically generalized onset. It is a generalized seizure characterized by an interruption of activities, a blank stare, and usually the person will be unresponsive when spoken to. Any ictal motor phenomena are minor in comparison to these non-motor features. Evidence: TAS. Frequency: Frequent (HP:0040282). (ORPHA:1941)
- Anxiety (HP:0000739): Intense feelings of nervousness, tension, or panic often arise in response to interpersonal stresses. There is worry about the negative effects of past unpleasant experiences and future negative possibilities. Individuals may feel fearful, apprehensive, or threatened by uncertainty, and they may also have fears of falling apart or losing control. Evidence: TAS. Frequency: Occasional (HP:0040283). (ORPHA:1941)
- Specific learning disability (HP:0001328): Impairment of certain skills such as reading or writing, coordination, self-control, or attention that interfere with the ability to learn. The impairment is not related to a global deficiency of intelligence. Evidence: TAS. Frequency: Occasional (HP:0040283). (ORPHA:1941)
These phenotypes are associated with the disease Juvenile absence epilepsy (ORPHA:1941).